Phenotypes associated with the disease orthostatic hypotensive disorder, Streeten type (OMIM:143850):
- Orthostatic hypotension (HP:0001278): A form of hypotension characterized by a sudden fall in blood pressure that occurs when a person assumes a standing position. Evidence: TAS. (OMIM:143850)
- Facial erythema (HP:0001041): Redness of the skin of the face, caused by hyperemia of the capillaries in the lower layers of the skin. Evidence: TAS. (OMIM:143850)
- Bruising susceptibility (HP:0000978): An ecchymosis (bruise) refers to the skin discoloration caused by the escape of blood into the tissues from ruptured blood vessels. This term refers to an abnormally increased susceptibility to bruising. The corresponding phenotypic abnormality is generally elicited on medical history as a report of frequent ecchymoses or bruising without adequate trauma. Evidence: TAS. (OMIM:143850)
- Syncope (HP:0001279): A transient loss of consciousness (i.e., characterized by a rapid onset, a short duration, and a spontaneous and complete recovery) due to cerebral hypoperfusion. Evidence: TAS. (OMIM:143850)
- Autosomal dominant inheritance (HP:0000006): A mode of inheritance that is observed for traits related to a gene encoded on one of the autosomes (i.e., the human chromosomes 1-22) in which a trait manifests in heterozygotes. In the context of medical genetics, an autosomal dominant disorder is caused when a single copy of the mutant allele is present. Males and females are affected equally, and can both transmit the disorder with a risk of 50% for each child of inheriting the mutant allele. Evidence: TAS. (OMIM:143850)